- Sensorineural hearing impairment (HP:0000407): A type of hearing impairment in one or both ears related to an abnormal functionality of the cochlear nerve. Evidence: PCS. (PMID:26522471)
- Autosomal dominant inheritance (HP:0000006): A mode of inheritance that is observed for traits related to a gene encoded on one of the autosomes (i.e., the human chromosomes 1-22) in which a trait manifests in heterozygotes. In the context of medical genetics, an autosomal dominant disorder is caused when a single copy of the mutant allele is present. Males and females are affected equally, and can both transmit the disorder with a risk of 50% for each child of inheriting the mutant allele. Evidence: PCS. (PMID:26522471)
These phenotypes are associated with the disease autosomal dominant nonsyndromic hearing loss 69 (OMIM:616697).